Phenotypes associated with the disease Wilms tumor 4 (OMIM:601363):
- Nephroblastoma (HP:0002667): The presence of a nephroblastoma, which is a neoplasm of the kidney that primarily affects children. Evidence: IEA. (OMIM:601363)
- Autosomal dominant inheritance (HP:0000006): A mode of inheritance that is observed for traits related to a gene encoded on one of the autosomes (i.e., the human chromosomes 1-22) in which a trait manifests in heterozygotes. In the context of medical genetics, an autosomal dominant disorder is caused when a single copy of the mutant allele is present. Males and females are affected equally, and can both transmit the disorder with a risk of 50% for each child of inheriting the mutant allele. Evidence: IEA. (OMIM:601363)